- High palate (HP:0000218): Height of the palate more than 2 SD above the mean (objective) or palatal height at the level of the first permanent molar more than twice the height of the teeth (subjective). Evidence: TAS. Frequency: Frequent (HP:0040282). (ORPHA:502423)
- Long face (HP:0000276): Facial height (length) is more than 2 standard deviations above the mean (objective); or, an apparent increase in the height (length) of the face (subjective). Evidence: TAS. Frequency: Frequent (HP:0040282). (ORPHA:502423)
- Micrognathia (HP:0000347): Developmental hypoplasia of the mandible. Evidence: TAS. Frequency: Frequent (HP:0040282). (ORPHA:502423)
- Hearing impairment (HP:0000365): A decreased magnitude of the sensory perception of sound. Evidence: TAS. Frequency: Frequent (HP:0040282). (ORPHA:502423)
- Hypotelorism (HP:0000601): Interpupillary distance less than 2 SD below the mean (alternatively, the appearance of an decreased interpupillary distance or closely spaced eyes). Evidence: TAS. Frequency: Frequent (HP:0040282). (ORPHA:502423)
- Depression (HP:0000716): Frequently experiencing feelings of being down, miserable, and/or hopeless; struggling to recover from these moods; having a pessimistic outlook on the future; feeling a pervasive sense of shame; having a low self-worth; experiencing thoughts of suicide and engaging in suicidal behavior. Evidence: TAS. Frequency: Frequent (HP:0040282). (ORPHA:502423)
- Anxiety (HP:0000739): Intense feelings of nervousness, tension, or panic often arise in response to interpersonal stresses. There is worry about the negative effects of past unpleasant experiences and future negative possibilities. Individuals may feel fearful, apprehensive, or threatened by uncertainty, and they may also have fears of falling apart or losing control. Evidence: TAS. Frequency: Frequent (HP:0040282). (ORPHA:502423)
- Delayed speech and language development (HP:0000750): A degree of language development that is significantly below the norm for a child of a specified age. Evidence: TAS. Frequency: Frequent (HP:0040282). (ORPHA:502423)
- Pectus excavatum (HP:0000767): A defect of the chest wall characterized by a depression of the sternum, giving the chest ("pectus") a caved-in ("excavatum") appearance. Evidence: TAS. Frequency: Frequent (HP:0040282). (ORPHA:502423)
- Primary amenorrhea (HP:0000786). Evidence: TAS. Frequency: Frequent (HP:0040282). (ORPHA:502423)
- Hyperthyroidism (HP:0000836): An abnormality of thyroid physiology characterized by excessive secretion of the thyroid hormones thyroxine (i.e., T4) and/or 3,3',5-triiodo-L-thyronine zwitterion (i.e., triiodothyronine or T3). Evidence: TAS. Frequency: Frequent (HP:0040282). (ORPHA:502423)
- Increased circulating prolactin concentration (HP:0000870): The presence of abnormally increased levels of prolactin in the blood. Prolactin is a peptide hormone produced by the anterior pituitary gland that plays a role in breast development and lactation during pregnancy. Evidence: TAS. Frequency: Frequent (HP:0040282). (ORPHA:502423)
- Mild intellectual disability (HP:0001256): Mild intellectual disability (ID) is defined as a type of ID characterized by mildly sub-average adaptive functioning and intellectual functioning, with an intelligence quotient (IQ) the range of 50-69. Evidence: TAS. Frequency: Frequent (HP:0040282). (ORPHA:502423)
- Hyporeflexia (HP:0001265): Reduction of neurologic reflexes such as the knee-jerk reaction. Evidence: TAS. Frequency: Frequent (HP:0040282). (ORPHA:502423)
- Motor delay (HP:0001270): A type of Developmental delay characterized by a delay in acquiring motor skills. Evidence: TAS. Frequency: Frequent (HP:0040282). (ORPHA:502423)
- Gait disturbance (HP:0001288): The term gait disturbance can refer to any disruption of the ability to walk. Evidence: TAS. Frequency: Frequent (HP:0040282). (ORPHA:502423)
- Generalized hypotonia (HP:0001290): Generalized muscular hypotonia (abnormally low muscle tone). Evidence: TAS. Frequency: Frequent (HP:0040282). (ORPHA:502423)
- Dysmetria (HP:0001310): A type of ataxia characterized by the inability to carry out movements with the correct range and motion across the plane of more than one joint related to incorrect estimation of the distances required for targeted movements. Evidence: TAS. Frequency: Frequent (HP:0040282). (ORPHA:502423)
- Cerebellar hypoplasia (HP:0001321): Cerebellar hypoplasia is a descriptive term implying a cerebellum with a reduced volume, but a normal shape and is stable over time. Evidence: TAS. Frequency: Frequent (HP:0040282). (ORPHA:502423)
- Tremor (HP:0001337): An unintentional, oscillating to-and-fro muscle movement about a joint axis. Evidence: TAS. Frequency: Frequent (HP:0040282). (ORPHA:502423)
- Growth delay (HP:0001510): A deficiency or slowing down of growth pre- and postnatally. Evidence: TAS. Frequency: Frequent (HP:0040282). (ORPHA:502423)
- Pes cavus (HP:0001761): An increase in height of the medial longitudinal arch of the foot that does not flatten on weight bearing (i.e., a distinctly hollow form of the sole of the foot when it is bearing weight). Evidence: TAS. Frequency: Frequent (HP:0040282). (ORPHA:502423)
- Progressive cerebellar ataxia (HP:0002073). Evidence: TAS. Frequency: Frequent (HP:0040282). (ORPHA:502423)
- Dysdiadochokinesis (HP:0002075): A type of ataxia characterized by the impairment of the ability to perform rapidly alternating movements, such as pronating and supinating his or her hand on the dorsum of the other hand as rapidly as possible. Evidence: TAS. Frequency: Frequent (HP:0040282). (ORPHA:502423)
- Scoliosis (HP:0002650): The presence of an abnormal lateral curvature of the spine. Evidence: TAS. Frequency: Frequent (HP:0040282). (ORPHA:502423)
- Delayed skeletal maturation (HP:0002750): A decreased rate of skeletal maturation. Delayed skeletal maturation can be diagnosed on the basis of an estimation of the bone age from radiographs of specific bones in the human body. Evidence: TAS. Frequency: Frequent (HP:0040282). (ORPHA:502423)
- Generalized joint hypermobility (HP:0002761): Joint hypermobility (ability of a joint to move beyond its normal range of motion) affecting many or all joints of the body. In individuals with Joint hypermobility at multiple sites (usually five or more), the term generalized joint hypermobility is preferred. Evidence: TAS. Frequency: Frequent (HP:0040282). (ORPHA:502423)
- Myalgia (HP:0003326): Pain in muscle. Evidence: TAS. Frequency: Frequent (HP:0040282). (ORPHA:502423)
- Gowers sign (HP:0003391): A phenomenon whereby patients are not able to stand up without the use of the hands owing to weakness of the proximal muscles of the lower limbs. Evidence: TAS. Frequency: Frequent (HP:0040282). (ORPHA:502423)
- EMG: myopathic abnormalities (HP:0003458): The presence of abnormal electromyographic patterns indicative of myopathy, such as small-short polyphasic motor unit potentials. Evidence: TAS. Frequency: Frequent (HP:0040282). (ORPHA:502423)
- Somatic sensory dysfunction (HP:0003474): An abnormality of the primary sensation that is mediated by peripheral nerves (pain, temperature, touch, vibration, joint position). The word hypoesthesia (or hypesthesia) refers to a reduction in cutaneous sensation to a specific type of testing. Evidence: TAS. Frequency: Frequent (HP:0040282). (ORPHA:502423)
- Increased variability in muscle fiber diameter (HP:0003557): An abnormally high degree of muscle fiber size variation. This phenotypic feature can be observed upon muscle biopsy. Evidence: TAS. Frequency: Frequent (HP:0040282). (ORPHA:502423)
- Proximal muscle weakness (HP:0003701): A lack of strength of the proximal muscles. Evidence: TAS. Frequency: Frequent (HP:0040282). (ORPHA:502423)
- Mitochondrial myopathy (HP:0003737): A type of myopathy associated with mitochondrial disease and characterized by findings on biopsy such as ragged red muscle fibers. Evidence: TAS. Frequency: Frequent (HP:0040282). (ORPHA:502423)
- Short stature (HP:0004322): A height below that which is expected according to age and gender norms. Although there is no universally accepted definition of short stature, many refer to "short stature" as height more than 2 standard deviations below the mean for age and gender (or below the 3rd percentile for age and gender dependent norms). Evidence: TAS. Frequency: Frequent (HP:0040282). (ORPHA:502423)
- Mildly elevated creatine kinase (HP:0008180). Evidence: TAS. Frequency: Frequent (HP:0040282). (ORPHA:502423)
- Increased muscle glycogen content (HP:0009051): An increased amount of glycogen in muscle tissue. Evidence: TAS. Frequency: Frequent (HP:0040282). (ORPHA:502423)
- Lipoma (HP:0012032): Benign neoplasia derived from lipoblasts or lipocytes of white or brown fat. May be angiomatous or hibernomatous. Evidence: TAS. Frequency: Frequent (HP:0040282). (ORPHA:502423)
- Increased intramyocellular lipid droplets (HP:0012240): An abnormal increase in intracellular lipid droplets In a muscle. The number and size of these drops can increase with somd disorders of lipid metabolism affecting muscle. See PMID 20691590 for histological images. Evidence: TAS. Frequency: Frequent (HP:0040282). (ORPHA:502423)
- Weakness of facial musculature (HP:0030319): Reduced strength of one or more muscles innervated by the facial nerve (the seventh cranial nerve). Evidence: TAS. Frequency: Frequent (HP:0040282). (ORPHA:502423)
- Hyperintensity of cerebral white matter on MRI (HP:0030890): A brighter than expected signal on magnetic resonance imaging emanating from the cerebral white matter. Evidence: TAS. Frequency: Frequent (HP:0040282). (ORPHA:502423)
- Thick hair (HP:0100874): Increased density of hairs, i.e., and elevated number of hairs per unit area. Evidence: TAS. Frequency: Frequent (HP:0040282). (ORPHA:502423)
- Abnormality of globe size (HP:0100887): An abnormality in the size of the ocular globe (eyeball). Evidence: TAS. Frequency: Frequent (HP:0040282). (ORPHA:502423)
- Autistic behavior (HP:0000729): Persistent deficits in social interaction and communication and interaction as well as a markedly restricted repertoire of activity and interest as well as repetitive patterns of behavior. Evidence: TAS. Frequency: Occasional (HP:0040283). (ORPHA:502423)
- Schizophrenia (HP:0100753): A mental disorder characterized by a disintegration of thought processes and emotional responsiveness. It most commonly manifests as auditory hallucinations, paranoid or bizarre delusions, or disorganized speech and thinking. It is accompanied by significant social or occupational dysfunction. The onset of symptoms typically occurs in young adulthood, with a global lifetime prevalence of about 1%. This term is not a helpful parent term to describe abnormal experiences. Evidence: TAS. Frequency: Occasional (HP:0040283). (ORPHA:502423)
- Optic disc pallor (HP:0000543): A pale yellow discoloration of the optic disc (the area of the optic nerve head in the retina). The optic disc normally has a pinkish hue with a central yellowish depression. Evidence: TAS. Frequency: Very rare (HP:0040284). (ORPHA:502423)
- Pigmentary retinopathy (HP:0000580): An abnormality of the retina characterized by pigment deposition. It is typically associated with migration and proliferation of macrophages or retinal pigment epithelial cells into the retina; melanin from these cells causes the pigmentary changes. Pigmentary retinopathy is a common final pathway of many retinal conditions and is often associated with visual loss. Evidence: TAS. Frequency: Very rare (HP:0040284). (ORPHA:502423)
These phenotypes are associated with the disease Mitochondrial myopathy-cerebellar ataxia-pigmentary retinopathy syndrome (ORPHA:502423).